Phenotypes associated with the disease hairy nose tip (OMIM:139630):
- Abnormal hair morphology (HP:0001595): An abnormality of the hair. Evidence: IEA. (OMIM:139630)